- Sensorineural hearing impairment (HP:0000407): A type of hearing impairment in one or both ears related to an abnormal functionality of the cochlear nerve. Evidence: PCS. Onset: Infantile onset (HP:0003593). (PMID:9949200)
- Autosomal recessive inheritance (HP:0000007): A mode of inheritance that is observed for traits related to a gene encoded on one of the autosomes (i.e., the human chromosomes 1-22) in which a trait manifests in individuals with two pathogenic alleles, either homozygotes (two copies of the same mutant allele) or compound heterozygotes (whereby each copy of a gene has a distinct mutant allele). Evidence: PCS. (PMID:9949200)
These phenotypes are associated with the disease autosomal recessive nonsyndromic hearing loss 21 (OMIM:603629).